- Anaplastic thyroid carcinoma (HP:0011779). Evidence: TAS. Frequency: Obligate (HP:0040280). (ORPHA:142)
- Broad neck (HP:0000475): Increased side-to-side width of the neck. Evidence: TAS. Frequency: Very frequent (HP:0040281). (ORPHA:142)
- Goiter (HP:0000853): An enlargement of the thyroid gland. Evidence: TAS. Frequency: Very frequent (HP:0040281). (ORPHA:142)
- Hoarse voice (HP:0001609): Hoarseness refers to a change in the pitch or quality of the voice, with the voice sounding weak, very breathy, scratchy, or husky. Evidence: TAS. Frequency: Very frequent (HP:0040281). (ORPHA:142)
- Nodular goiter (HP:0005994): Enlargement of the thyroid gland related to one or more nodules in the thyroid gland. Evidence: TAS. Frequency: Very frequent (HP:0040281). (ORPHA:142)
- Vocal cord paralysis (HP:0001605): A loss of the ability to move the vocal folds. Evidence: TAS. Frequency: Frequent (HP:0040282). (ORPHA:142)
- Dysphagia (HP:0002015): Difficulty in swallowing. Evidence: TAS. Frequency: Frequent (HP:0040282). (ORPHA:142)
- Respiratory distress (HP:0002098): Respiratory distress is objectively observable as the physical or emotional consequences from the experience of dyspnea. The physical presentation of respiratory distress is generally referred to as labored breathing, while the sensation of respiratory distress is called shortness of breath or dyspnea. Evidence: TAS. Frequency: Frequent (HP:0040282). (ORPHA:142)
- Lymphadenopathy (HP:0002716): Enlargement (swelling) of a lymph node. Evidence: TAS. Frequency: Frequent (HP:0040282). (ORPHA:142)
- Upper airway obstruction (HP:0002781): Increased resistance to the passage of air in the upper airway. Evidence: TAS. Frequency: Frequent (HP:0040282). (ORPHA:142)
- Laryngotracheal stenosis (HP:0004894). Evidence: TAS. Frequency: Frequent (HP:0040282). (ORPHA:142)
- Pain (HP:0012531): An unpleasant sensory and emotional experience associated with actual or potential tissue damage, or described in terms of such damage. Evidence: TAS. Frequency: Frequent (HP:0040282). (ORPHA:142)
- Neoplasm of the lung (HP:0100526): Tumor of the lung. Evidence: TAS. Frequency: Frequent (HP:0040282). (ORPHA:142)
- Dysphonia (HP:0001618): Difficulty in speaking due to a physical disorder of the mouth, tongue, throat, or vocal cords. Associated with a known physical or neurological cause. Evidence: TAS. Frequency: Occasional (HP:0040283). (ORPHA:142)
- Weight loss (HP:0001824): Reduction of total body weight. Evidence: TAS. Frequency: Occasional (HP:0040283). (ORPHA:142)
- Dyspnea (HP:0002094): Difficult or labored breathing. Dyspnea is a subjective feeling only the patient can rate, e.g., on a Borg scale. Evidence: TAS. Frequency: Occasional (HP:0040283). (ORPHA:142)
- Hemoptysis (HP:0002105): Coughing up (expectoration) of blood or blood-streaked sputum from the larynx, trachea, bronchi, or lungs. Evidence: TAS. Frequency: Occasional (HP:0040283). (ORPHA:142)
- Stridor (HP:0010307): Stridor is a high pitched sound resulting from turbulent air flow in the upper airway. Evidence: TAS. Frequency: Occasional (HP:0040283). (ORPHA:142)
- Neoplasm of the skeletal system (HP:0010622): A tumor (abnormal growth of tissue) of the skeleton. Evidence: TAS. Frequency: Occasional (HP:0040283). (ORPHA:142)
- Abnormal skeletal muscle morphology (HP:0011805): A structural abnormality of a skeletal muscle. Evidence: TAS. Frequency: Occasional (HP:0040283). (ORPHA:142)
- Cough (HP:0012735): A sudden, audible expulsion of air from the lungs through a partially closed glottis, preceded by inhalation. Evidence: TAS. Frequency: Occasional (HP:0040283). (ORPHA:142)
- Tracheoesophageal fistula (HP:0002575): An abnormal connection (fistula) between the esophagus and the trachea. Evidence: TAS. Frequency: Very rare (HP:0040284). (ORPHA:142)
- Malignant neoplasm of the central nervous system (HP:0100836): A tumor that originates in the pineal gland, has moderate cellularity and tends to form rosette patterns. Evidence: TAS. Frequency: Very rare (HP:0040284). (ORPHA:142)
These phenotypes are associated with the disease Anaplastic thyroid carcinoma (ORPHA:142).